Phenotypes associated with the disease Hyaluronidase deficiency (ORPHA:67041):
- Abnormal acetabulum morphology (HP:0003170): An abnormality of the acetabulum, i.e., the Acetabular part of hip bone, which together with the head of the femur forms the hip joint. Evidence: TAS. Frequency: Very frequent (HP:0040281). (ORPHA:67041)
- Short stature (HP:0004322): A height below that which is expected according to age and gender norms. Although there is no universally accepted definition of short stature, many refer to "short stature" as height more than 2 standard deviations below the mean for age and gender (or below the 3rd percentile for age and gender dependent norms). Evidence: TAS. Frequency: Very frequent (HP:0040281). (ORPHA:67041)